Phenotypes associated with the disease generalized epilepsy with febrile seizures plus, type 1 (OMIM:604233):
- Bilateral tonic-clonic seizure (HP:0002069): A bilateral tonic-clonic seizure is a seizure defined by a tonic (bilateral increased tone, lasting seconds to minutes) and then a clonic (bilateral sustained rhythmic jerking) phase. Evidence: TAS. (OMIM:604233)
- Febrile seizure (within the age range of 3 months to 6 years) (HP:0002373): A febrile seizure is any type of seizure (most often a generalized tonic-clonic seizure) occurring with fever (at least 38 degrees Celsius) but in the absence of central nervous system infection, severe metabolic disturbance or other alternative precipitant in children between the ages of 3 months and 6 years. Evidence: TAS. (OMIM:604233)
- Generalized non-motor (absence) seizure (HP:0002121): A generalized non-motor (absence) seizure is a type of a type of dialeptic seizure that is of electrographically generalized onset. It is a generalized seizure characterized by an interruption of activities, a blank stare, and usually the person will be unresponsive when spoken to. Any ictal motor phenomena are minor in comparison to these non-motor features. Evidence: TAS. (OMIM:604233)
- Atonic seizure (HP:0010819): Atonic seizure is a type of motor seizure characterized by a sudden loss or diminution of muscle tone without apparent preceding myoclonic or tonic event lasting about 1 to 2 seconds, involving head, trunk, jaw, or limb musculature. Evidence: TAS. (OMIM:604233)
- Typified by incomplete penetrance (HP:0003829): Description of conditions in which not all individuals with a given genotype exhibit the disease. Penetrance is the proportion that develop disease given a lifespan of 80 years. Evidence: TAS. (OMIM:604233)
- Autosomal dominant inheritance (HP:0000006): A mode of inheritance that is observed for traits related to a gene encoded on one of the autosomes (i.e., the human chromosomes 1-22) in which a trait manifests in heterozygotes. In the context of medical genetics, an autosomal dominant disorder is caused when a single copy of the mutant allele is present. Males and females are affected equally, and can both transmit the disorder with a risk of 50% for each child of inheriting the mutant allele. Evidence: TAS. (OMIM:604233)